Phenotypes associated with the disease Xq12-q13.3 duplication syndrome (ORPHA:314389):
- Cryptorchidism (HP:0000028): Testis in inguinal canal. That is, absence of one or both testes from the scrotum owing to failure of the testis or testes to descend through the inguinal canal to the scrotum. Evidence: TAS. Frequency: Very frequent (HP:0040281). (ORPHA:314389)
- Microcephaly (HP:0000252): Head circumference below 2 standard deviations below the mean for age and gender. Evidence: TAS. Frequency: Very frequent (HP:0040281). (ORPHA:314389)
- Epicanthus (HP:0000286): A fold of skin starting above the medial aspect of the upper eyelid and arching downward to cover, pass in front of and lateral to the medial canthus. Evidence: TAS. Frequency: Very frequent (HP:0040281). (ORPHA:314389)
- Hypertelorism (HP:0000316): Interpupillary distance more than 2 SD above the mean (alternatively, the appearance of an increased interpupillary distance or widely spaced eyes). Evidence: TAS. Frequency: Very frequent (HP:0040281). (ORPHA:314389)
- Triangular face (HP:0000325): Facial contour, as viewed from the front, triangular in shape, with breadth at the temples and tapering to a narrow chin. Evidence: TAS. Frequency: Very frequent (HP:0040281). (ORPHA:314389)
- Optic disc pallor (HP:0000543): A pale yellow discoloration of the optic disc (the area of the optic nerve head in the retina). The optic disc normally has a pinkish hue with a central yellowish depression. Evidence: TAS. Frequency: Very frequent (HP:0040281). (ORPHA:314389)
- Abnormality of visual evoked potentials (HP:0000649): An anomaly of visually evoked potentials (VEP), which are electrical potentials, initiated by brief visual stimuli, which are recorded from the scalp overlying the visual cortex. Evidence: TAS. Frequency: Very frequent (HP:0040281). (ORPHA:314389)
- Atypical behavior (HP:0000708): Atypical behavior is an abnormality in a person's actions that can be controlled or modulated by the will of the individual. While abnormal behaviors can be difficult to control, they are distinct from other abnormal actions that cannot be affected by the individual's will. Evidence: TAS. Frequency: Very frequent (HP:0040281). (ORPHA:314389)
- Agitation (HP:0000713): A state of excessive motor activity that is associated with mental distress or a feeling of substantial unease or inner tension. Distinguished from restlessness by the increased level of emotional distress and negative intensity of the experience. Agitation has a significant level of physical activity that is typically threatening to the self or others. Evidence: TAS. Frequency: Very frequent (HP:0040281). (ORPHA:314389)
- Autistic behavior (HP:0000729): Persistent deficits in social interaction and communication and interaction as well as a markedly restricted repertoire of activity and interest as well as repetitive patterns of behavior. Evidence: TAS. Frequency: Very frequent (HP:0040281). (ORPHA:314389)
- Delayed speech and language development (HP:0000750): A degree of language development that is significantly below the norm for a child of a specified age. Evidence: TAS. Frequency: Very frequent (HP:0040281). (ORPHA:314389)
- Global developmental delay (HP:0001263): A delay in the achievement of motor or mental milestones in the domains of development of a child, including motor skills, speech and language, cognitive skills, and social and emotional skills. This term should only be used to describe children younger than five years of age. Evidence: TAS. Frequency: Very frequent (HP:0040281). (ORPHA:314389)
- Pectus excavatum (HP:0000767): A defect of the chest wall characterized by a depression of the sternum, giving the chest ("pectus") a caved-in ("excavatum") appearance. Evidence: TAS. Frequency: Very frequent (HP:0040281). (ORPHA:314389)
- Cutaneous finger syndactyly (HP:0010554): A soft tissue continuity in the A/P axis between two fingers that extends distally to at least the level of the proximal interphalangeal joints, or a soft tissue continuity in the A/P axis between two fingers that lies significantly distal to the flexion crease that overlies the metacarpophalangeal joint of the adjacent fingers. Evidence: TAS. Frequency: Very frequent (HP:0040281). (ORPHA:314389)
- Intellectual disability (HP:0001249): The term intellectual disability or intellectual developmental disorder is used to describe significantly sub-average intellectual and adaptive functioning based on clinical assessment and as measured by individually administered, appropriately normed, standardized and validated tests of intellectual functioning and adaptive behavior, with onset during the developmental period from infancy through adolescence. Evidence: TAS. Frequency: Very frequent (HP:0040281). (ORPHA:314389)
- Hypotonia (HP:0001252): Hypotonia is an abnormally low muscle tone (the amount of tension or resistance to movement in a muscle). Even when relaxed, muscles have a continuous and passive partial contraction which provides some resistance to passive stretching. Hypotonia thus manifests as diminished resistance to passive stretching. Hypotonia is not the same as muscle weakness, although the two conditions can co-exist. Evidence: TAS. Frequency: Very frequent (HP:0040281). (ORPHA:314389)
- Eczematoid dermatitis (HP:0000964): Eczema is a form of dermatitis that is characterized by scaly, pruritic, erythematous lesions located on flexural surfaces. Evidence: TAS. Frequency: Very frequent (HP:0040281). (ORPHA:314389)
- Short stature (HP:0004322): A height below that which is expected according to age and gender norms. Although there is no universally accepted definition of short stature, many refer to "short stature" as height more than 2 standard deviations below the mean for age and gender (or below the 3rd percentile for age and gender dependent norms). Evidence: TAS. Frequency: Very frequent (HP:0040281). (ORPHA:314389)
- Hypoplasia of the corpus callosum (HP:0002079): Underdevelopment of the corpus callosum. Evidence: TAS. Frequency: Very frequent (HP:0040281). (ORPHA:314389)
- Ventriculomegaly (HP:0002119): An increase in size of the ventricular system of the brain. Evidence: TAS. Frequency: Very frequent (HP:0040281). (ORPHA:314389)
- Generalized myoclonic seizure (HP:0002123): A generalized myoclonic seizure is a type of generalized motor seizure characterized by bilateral, sudden, brief (<100 ms) involuntary single or multiple contraction of muscles or muscle groups of variable topography (axial, proximal limb, distal). Myoclonus is less regularly repetitive and less sustained than is clonus. Evidence: TAS. Frequency: Frequent (HP:0040282). (ORPHA:314389)
- Hypsarrhythmia (HP:0002521): Hypsarrhythmia is abnormal interictal high amplitude waves and a background of irregular spikes. There is continuous (during wakefulness), high-amplitude (>200 Hz), generalized polymorphic slowing with no organized background and multifocal spikes demonstrated by electroencephalography (EEG). Evidence: TAS. Frequency: Very frequent (HP:0040281). (ORPHA:314389)
- Everted lower lip vermilion (HP:0000232): An abnormal configuration of the lower lip such that it is turned outward i.e., everted, with the Inner aspect of the lower lip vermilion (normally opposing the teeth) being visible in a frontal view. Evidence: TAS. Frequency: Very frequent (HP:0040281). (ORPHA:314389)
- Recurrent upper respiratory tract infections (HP:0002788): An increased susceptibility to upper respiratory tract infections as manifested by a history of recurrent upper respiratory tract infections (running ears - otitis, sinusitis, pharyngitis, tonsillitis). Evidence: TAS. Frequency: Frequent (HP:0040282). (ORPHA:314389)
- Elevated circulating creatine kinase activity (HP:0003236): The activity of creatine kinase in the blood circulation is above the upper limit of normal. Evidence: TAS. Frequency: Very frequent (HP:0040281). (ORPHA:314389)
- Decreased circulating alkaline phosphatase activity (HP:0003282): Concentration or activity of alkaline phosphatase outside the upper or lower limtis of normal in the blood circulation. Evidence: TAS. Frequency: Very frequent (HP:0040281). (ORPHA:314389)
- Generalized amyotrophy (HP:0003700): Generalized (diffuse, unlocalized) amyotrophy (muscle atrophy) affecting multiple muscles. Evidence: TAS. Frequency: Very frequent (HP:0040281). (ORPHA:314389)
- 2-3 toe syndactyly (HP:0004691): Syndactyly with fusion of toes two and three. Evidence: TAS. Frequency: Very frequent (HP:0040281). (ORPHA:314389)
- Depressed nasal bridge (HP:0005280): Posterior positioning of the nasal root in relation to the overall facial profile for age. Evidence: TAS. Frequency: Very frequent (HP:0040281). (ORPHA:314389)
- Numerous nevi (HP:0001054). Evidence: TAS. Frequency: Very frequent (HP:0040281). (ORPHA:314389)
- Impaired pain sensation (HP:0007328): Reduced ability to perceive painful stimuli. Evidence: TAS. Frequency: Very frequent (HP:0040281). (ORPHA:314389)
- Anterior creases of earlobe (HP:0009908): Sharply demarcated, typically linear and approximately horizontal, indentations in the outer surface of the ear lobe. Evidence: TAS. Frequency: Very frequent (HP:0040281). (ORPHA:314389)
- Cleft earlobe (HP:0011265): Discontinuity in the convexity of the inferior margin of the lobe. Evidence: TAS. Frequency: Very frequent (HP:0040281). (ORPHA:314389)
- Moderate global developmental delay (HP:0011343): A moderate delay in the achievement of motor or mental milestones in the domains of development of a child. Evidence: TAS. Frequency: Very frequent (HP:0040281). (ORPHA:314389)
- Abnormal basal ganglia MRI signal intensity (HP:0012751): A deviation from normal signal on magnetic resonance imaging (MRI) of the basal ganglia. Evidence: TAS. Frequency: Very frequent (HP:0040281). (ORPHA:314389)
- Decreased circulating insulin-like growth factor 1 concentration (HP:0030353): The concentration of insulin-like growth factor 1 (IGF1) in the blood circulation is below the lower limit of normal. Evidence: TAS. Frequency: Very frequent (HP:0040281). (ORPHA:314389)
- Bulimia (HP:0100739): A form of anomalous eating behavior characterized by binge eating is followed by self-induced vomiting or other compensatory behavior intended to prevent weight gain (purging, fasting or exercising or a combination of these). Evidence: TAS. Frequency: Very frequent (HP:0040281). (ORPHA:314389)